- Polyhydramnios (HP:0001561): The presence of excess amniotic fluid in the uterus during pregnancy. Evidence: TAS. Frequency: Very frequent (HP:0040281). (ORPHA:1203)
- Duodenal atresia (HP:0002247): A developmental defect resulting in complete obliteration of the duodenal lumen, that is, an abnormal closure of the duodenum. Evidence: TAS. Frequency: Very frequent (HP:0040281). (ORPHA:1203)
- Premature birth (HP:0001622): The birth of a baby of less than 37 weeks of gestational age. Evidence: TAS. Frequency: Frequent (HP:0040282). (ORPHA:1203)
- Vomiting (HP:0002013): Forceful ejection of the contents of the stomach through the mouth by means of a series of involuntary spasmic contractions. Evidence: TAS. Frequency: Frequent (HP:0040282). (ORPHA:1203)
- Prenatal double bubble sign (HP:0025656): Sonographic detection of a double bubble sign in the upper abdomen is strongly indicative of duodenal obstruction. One bubble represents fetal stomach, and the other is attributed to a dilated proximal part of the duodenum; continuity between both bubbles is required for the sign. Evidence: TAS. Frequency: Frequent (HP:0040282). (ORPHA:1203)
- Failure to thrive (HP:0001508): Failure to thrive (FTT) refers to a child whose physical growth is substantially below the norm. Evidence: TAS. Frequency: Occasional (HP:0040283). (ORPHA:1203)
- Abnormality of the pancreas (HP:0001732): An abnormality of the pancreas. Evidence: TAS. Frequency: Occasional (HP:0040283). (ORPHA:1203)
- Annular pancreas (HP:0001734): A congenital anomaly in which the pancreas completely (or sometimes incompletely) encircles the second portion of duodenum and occasionally obstructs the more proximal duodenum. Evidence: TAS. Frequency: Occasional (HP:0040283). (ORPHA:1203)
- Weight loss (HP:0001824): Reduction of total body weight. Evidence: TAS. Frequency: Occasional (HP:0040283). (ORPHA:1203)
- Dehydration (HP:0001944). Evidence: TAS. Frequency: Occasional (HP:0040283). (ORPHA:1203)
- Projectile vomiting (HP:0002587): Vomiting that ejects the gastric contents with great force. Evidence: TAS. Frequency: Occasional (HP:0040283). (ORPHA:1203)
- Abdominal distention (HP:0003270): Distention of the abdomen. Evidence: TAS. Frequency: Occasional (HP:0040283). (ORPHA:1203)
- Abnormality of the pulmonary artery (HP:0004414): An abnormality of the pulmonary artery. Evidence: TAS. Frequency: Occasional (HP:0040283). (ORPHA:1203)
- Hypokalemic hypochloremic metabolic alkalosis (HP:0004909). Evidence: TAS. Frequency: Occasional (HP:0040283). (ORPHA:1203)
- Lack of bowel sounds (HP:0030145): Complete lack of abdominal sounds as assayed by examination of the abdomen with a stethoscope. Evidence: TAS. Frequency: Occasional (HP:0040283). (ORPHA:1203)
- Bilious emesis (HP:0034754): Vomiting whereby the vomit has the color of bile, yellowish-green. Evidence: TAS. Frequency: Occasional (HP:0040283). (ORPHA:1203)
These phenotypes are associated with the disease Duodenal atresia (ORPHA:1203).